- Sensorineural hearing impairment (HP:0000407): A type of hearing impairment in one or both ears related to an abnormal functionality of the cochlear nerve. Evidence: IEA. (OMIM:400043)
- Y-linked inheritance (HP:0001450): A mode of inheritance that is observed for traits related to a gene encoded on the Y chromosome. Evidence: IEA. (OMIM:400003)
- Tinnitus (HP:0000360): Tinnitus is an auditory perception that can be described as the experience of sound, in the ear or in the head, in the absence of external acoustic stimulation. Evidence: IEA. Frequency: Occasional (HP:0040283). (OMIM:400043)
These phenotypes are associated with the disease hearing loss, Y-linked 1 (OMIM:400043).